Phenotypes associated with the disease MYDRIATIC RESPONSE TO PHARMACOLOGIC AGENTS (OMIM:159410):
- Autosomal dominant inheritance (HP:0000006): A mode of inheritance that is observed for traits related to a gene encoded on one of the autosomes (i.e., the human chromosomes 1-22) in which a trait manifests in heterozygotes. In the context of medical genetics, an autosomal dominant disorder is caused when a single copy of the mutant allele is present. Males and females are affected equally, and can both transmit the disorder with a risk of 50% for each child of inheriting the mutant allele. Evidence: IEA. (OMIM:159410)
- Abnormality of the eye (HP:0000478): Any abnormality of the eye, including location, spacing, and intraocular abnormalities. Evidence: IEA. (OMIM:159410)